Phenotypes associated with the disease mitochondrial complex I deficiency, nuclear type 32 (OMIM:618252):
- Skeletal muscle atrophy (HP:0003202): The presence of skeletal muscular atrophy (which is also known as amyotrophy). Evidence: PCS. Frequency: 1/2. (PMID:29429571)
- Cerebral atrophy (HP:0002059): Atrophy (wasting, decrease in size of cells or tissue) affecting the cerebrum. Evidence: PCS. Frequency: 1/2. (PMID:29429571)
- Vomiting (HP:0002013): Forceful ejection of the contents of the stomach through the mouth by means of a series of involuntary spasmic contractions. Evidence: PCS. Frequency: 1/2. (PMID:29429571)
- Seizure (HP:0001250): A seizure is an intermittent abnormality of nervous system physiology characterized by a transient occurrence of signs and/or symptoms due to abnormal excessive or synchronous neuronal activity in the brain. Evidence: PCS. Frequency: 1/2. (PMID:29429571)
- Global developmental delay (HP:0001263): A delay in the achievement of motor or mental milestones in the domains of development of a child, including motor skills, speech and language, cognitive skills, and social and emotional skills. This term should only be used to describe children younger than five years of age. Evidence: PCS. Frequency: 2/2. (PMID:29429571)
- Increased circulating lactate concentration (HP:0002151): Abnormally increased level of blood lactate (2-hydroxypropanoic acid). Lactate is produced from pyruvate by lactate dehydrogenase during normal metabolism. The terms lactate and lactic acid are often used interchangeably but lactate (the component measured in blood) is strictly a weak base whereas lactic acid is the corresponding acid. Lactic acidosis is often used clinically to describe elevated lactate but should be reserved for cases where there is a corresponding acidosis (pH below 7.35). Evidence: PCS. Frequency: 2/2. (PMID:29429571)
- Infantile onset (HP:0003593): Onset of signs or symptoms of disease between 28 days to one year of life. Evidence: PCS. Frequency: 2/2. (PMID:29429571)
- Generalized hypotonia (HP:0001290): Generalized muscular hypotonia (abnormally low muscle tone). Evidence: PCS. Frequency: 2/2. (PMID:29429571)
- Increased CSF lactate (HP:0002490): Increased concentration of lactate in the cerebrospinal fluid. Evidence: PCS. Frequency: 4/4. (PMID:29429571)
- Decreased activity of mitochondrial complex I (HP:0011923): A reduction in the activity of the mitochondrial respiratory chain complex I, which is part of the electron transport chain in mitochondria. Evidence: PCS. Frequency: 1/1. (PMID:29429571)
- Patent urachus (HP:0010479): Persistence of the urachal canal resulting in a canal between the bladder and the umbilicus. Evidence: PCS. Frequency: 1/2. (PMID:29429571)
- Death in childhood (HP:0003819): Death in during childhood, defined here as between the ages of 2 and 10 years. Evidence: PCS. Frequency: 1/2. (PMID:29429571)
- Failure to thrive (HP:0001508): Failure to thrive (FTT) refers to a child whose physical growth is substantially below the norm. Evidence: PCS. Frequency: 1/2. (PMID:29429571)
- Small for gestational age (HP:0001518): Smaller than normal size according to sex and gestational age related norms, defined as a weight below the 10th percentile for the gestational age. Evidence: PCS. Frequency: 1/2. (PMID:29429571)
- Hyponatremia (HP:0002902): The concentration of sodium in the blood circulation is below the lower limit of normal. Evidence: PCS. Frequency: 1/2. (PMID:29429571)
- Autosomal recessive inheritance (HP:0000007): A mode of inheritance that is observed for traits related to a gene encoded on one of the autosomes (i.e., the human chromosomes 1-22) in which a trait manifests in individuals with two pathogenic alleles, either homozygotes (two copies of the same mutant allele) or compound heterozygotes (whereby each copy of a gene has a distinct mutant allele). Evidence: PCS. (PMID:29429571)
- Respiratory failure (HP:0002878): A severe form of respiratory insufficiency characterized by inadequate gas exchange such that the levels of oxygen or carbon dioxide cannot be maintained within normal limits. Evidence: PCS. Frequency: 1/2. (PMID:29429571)
- Metabolic acidosis (HP:0001942): Metabolic acidosis (MA) is characterized by a fall in blood pH due to a reduction of serum bicarbonate concentration. This can occur as a result of either the accumulation of acids (high anion gap MA) or the loss of bicarbonate from the gastrointestinal tract or the kidney (hyperchloremic MA). By definition, MA is not due to a respirary cause. Evidence: PCS. Frequency: 2/2. (PMID:29429571)